- Corneal opacity (HP:0007957): A reduction of corneal clarity. Evidence: TAS. (OMIM:609140)
- Corneal dystrophy (HP:0001131): The term corneal dystrophy embraces a heterogenous group of bilateral genetically determined non-inflammatory corneal diseases that are restricted to the cornea. Evidence: TAS. (OMIM:609140)
- Autosomal dominant inheritance (HP:0000006): A mode of inheritance that is observed for traits related to a gene encoded on one of the autosomes (i.e., the human chromosomes 1-22) in which a trait manifests in heterozygotes. In the context of medical genetics, an autosomal dominant disorder is caused when a single copy of the mutant allele is present. Males and females are affected equally, and can both transmit the disorder with a risk of 50% for each child of inheriting the mutant allele. Evidence: TAS. (OMIM:609140)
These phenotypes are associated with the disease posterior polymorphous corneal dystrophy 2 (OMIM:609140).